- Abnormality of the face (HP:0000271): An abnormality of the face. Evidence: IEA. (OMIM:161470)
- Autosomal dominant inheritance (HP:0000006): A mode of inheritance that is observed for traits related to a gene encoded on one of the autosomes (i.e., the human chromosomes 1-22) in which a trait manifests in heterozygotes. In the context of medical genetics, an autosomal dominant disorder is caused when a single copy of the mutant allele is present. Males and females are affected equally, and can both transmit the disorder with a risk of 50% for each child of inheriting the mutant allele. Evidence: IEA. (OMIM:161470)
These phenotypes are associated with the disease nasal alar collapse, bilateral (OMIM:161470).